- Downslanted palpebral fissures (HP:0000494): The palpebral fissure inclination is more than two standard deviations below the mean. Evidence: TAS. (OMIM:609640)
- Short stature (HP:0004322): A height below that which is expected according to age and gender norms. Although there is no universally accepted definition of short stature, many refer to "short stature" as height more than 2 standard deviations below the mean for age and gender (or below the 3rd percentile for age and gender dependent norms). Evidence: TAS. (OMIM:609640)
- Global developmental delay (HP:0001263): A delay in the achievement of motor or mental milestones in the domains of development of a child, including motor skills, speech and language, cognitive skills, and social and emotional skills. This term should only be used to describe children younger than five years of age. Evidence: TAS. (OMIM:609640)
- Ptosis (HP:0000508): The upper eyelid margin is positioned 3 mm or more lower than usual and covers the superior portion of the iris (objective); or, the upper lid margin obscures at least part of the pupil (subjective). Evidence: TAS. (OMIM:609640)
- Hypertelorism (HP:0000316): Interpupillary distance more than 2 SD above the mean (alternatively, the appearance of an increased interpupillary distance or widely spaced eyes). Evidence: TAS. (OMIM:609640)
- Cupped ear (HP:0000378): Laterally protruding ear that lacks antihelical folding (including absence of inferior and superior crura). Evidence: TAS. (OMIM:609640)
- Proptosis (HP:0000520): An eye that is protruding anterior to the plane of the face to a greater extent than is typical. Evidence: TAS. (OMIM:609640)
- Posteriorly rotated ears (HP:0000358): A type of abnormal location of the ears in which the position of the ears is characterized by posterior rotation (the superior part of the ears is rotated towards the back of the head, and the inferior part of the ears towards the front). Evidence: TAS. (OMIM:609640)
- Micrognathia (HP:0000347): Developmental hypoplasia of the mandible. Evidence: TAS. (OMIM:609640)
- Autosomal dominant inheritance (HP:0000006): A mode of inheritance that is observed for traits related to a gene encoded on one of the autosomes (i.e., the human chromosomes 1-22) in which a trait manifests in heterozygotes. In the context of medical genetics, an autosomal dominant disorder is caused when a single copy of the mutant allele is present. Males and females are affected equally, and can both transmit the disorder with a risk of 50% for each child of inheriting the mutant allele. Evidence: TAS. (OMIM:609640)
These phenotypes are associated with the disease Frias syndrome (OMIM:609640).